Phenotypes associated with the disease PANDAS (ORPHA:66624):
- Tics (HP:0100033): Repeated, individually recognizable, intermittent movements or movement fragments that are almost always briefly suppressible and are usually associated with awareness of an urge to perform the movement. Evidence: TAS. Frequency: Very frequent (HP:0040281). (ORPHA:66624)
- Emotional lability (HP:0000712): Unstable emotional experiences and frequent mood changes; emotions that are easily aroused, intense, and/or disproportionate to events and circumstances. Evidence: TAS. Frequency: Frequent (HP:0040282). (ORPHA:66624)
- Depression (HP:0000716): Frequently experiencing feelings of being down, miserable, and/or hopeless; struggling to recover from these moods; having a pessimistic outlook on the future; feeling a pervasive sense of shame; having a low self-worth; experiencing thoughts of suicide and engaging in suicidal behavior. Evidence: TAS. Frequency: Frequent (HP:0040282). (ORPHA:66624)
- Irritability (HP:0000737): An emotional state characterized by negative feelings of heightened frustration, annoyance, or feeling upset, often triggered by internal factors (e.g., fatigue, hunger, unfulfilled desires) or external factors (e.g., social or environmental challenges). Irritability may be unpredictable, and is accompanied by a lowered threshold for emotional reactivity and observable features (speech, facial expressions, or psychomotor activity). Evidence: TAS. Frequency: Frequent (HP:0040282). (ORPHA:66624)
- Personality changes (HP:0000751): An abnormal shift in patterns of thinking, acting, or feeling. Evidence: TAS. Frequency: Frequent (HP:0040282). (ORPHA:66624)
- Chorea (HP:0002072): Chorea (Greek for 'dance') refers to widespread arrhythmic involuntary movements of a forcible, jerky and restless fashion. It is a random-appearing sequence of one or more discrete involuntary movements or movement fragments. Movements appear random because of variability in timing, duration or location. Each movement may have a distinct start and end. However, movements may be strung together and thus may appear to flow randomly from one muscle group to another. Chorea can involve the trunk, neck, face, tongue, and extremities. Evidence: TAS. Frequency: Frequent (HP:0040282). (ORPHA:66624)
- Sleep disturbance (HP:0002360): An abnormal pattern in the quality, quantity, or characteristics of sleep. Evidence: TAS. Frequency: Frequent (HP:0040282). (ORPHA:66624)
- Developmental regression (HP:0002376): Loss of developmental skills, as manifested by loss of developmental milestones. Evidence: TAS. Frequency: Frequent (HP:0040282). (ORPHA:66624)
- Attention deficit hyperactivity disorder (HP:0007018): Attention deficit hyperactivity disorder (ADHD) manifests at age 2-3 years or by first grade at the latest. The main symptoms are distractibility, impulsivity, hyperactivity, and often trouble organizing tasks and projects, difficulty going to sleep, and social problems from being aggressive, loud, or impatient. Evidence: TAS. Frequency: Frequent (HP:0040282). (ORPHA:66624)
- Obsessive-compulsive trait (HP:0008770): The presence of one or more obsessive-compulsive personality traits. Obsessions refer to persistent intrusive thoughts, and compulsions to intrusive behaviors, which the affected person experiences as involuntary, senseless, or repugnant. Evidence: TAS. Frequency: Frequent (HP:0040282). (ORPHA:66624)
- Oppositional defiant disorder (HP:0010865): An enduring pattern of uncooperative, defiant, and hostile behavior towards authority figures that does not involve major antisocial violations, is not accounted for by the child's developmental stage, and results in significant functional impairment. A certain level of oppositional behavior is common in children and adolescents. Evidence: TAS. Frequency: Frequent (HP:0040282). (ORPHA:66624)
- Impulsivity (HP:0100710): Acting on the spur of the moment or on a momentary basis without consideration of outcomes; having difficulty establishing or following plans; experiencing a sense of urgency and engaging in behavior that is uninhibited, cannot be inhibited, and is uncontrolled. The possibility of repression is inconceivable. Evidence: TAS. Frequency: Frequent (HP:0040282). (ORPHA:66624)
- Abnormal fear-induced behavior (HP:0100852): An abnormal fear-induced behavior includes observable actions. This behavior is characterized by abnormal responses to fear or abnormal fear levels. Examples of such behavior include avoiding fear-inducing situations. Evidence: TAS. Frequency: Frequent (HP:0040282). (ORPHA:66624)
- Agoraphobia (HP:0000756): A type of anxiety disorder characterized by the avoidance of public places, especially where crowds gather. Evidence: TAS. Frequency: Occasional (HP:0040283). (ORPHA:66624)
- Enuresis (HP:0000805): Lack of the ability to control the urinary bladder leading to involuntary urination at an age where control of the bladder should already be possible. Evidence: TAS. Frequency: Occasional (HP:0040283). (ORPHA:66624)
- Anorexia (HP:0002039): Lack of desire to eat (loss of appetite). Evidence: TAS. Frequency: Occasional (HP:0040283). (ORPHA:66624)
- Phonophobia (HP:0002183): An abnormally heightened sensitivity to loud sounds. Evidence: TAS. Frequency: Occasional (HP:0040283). (ORPHA:66624)
- Clumsiness (HP:0002312): Lack of physical coordination resulting in an abnormal tendency to drop items or bump into objects. Evidence: TAS. Frequency: Occasional (HP:0040283). (ORPHA:66624)
- Arthralgia (HP:0002829): Joint pain. Evidence: TAS. Frequency: Occasional (HP:0040283). (ORPHA:66624)
- Recurrent streptococcus pneumoniae infections (HP:0005366): Increased susceptibility to streptococcus pneumoniae infections as manifested by a history of recurrent infections by streptococcus pneumoniae. Evidence: TAS. Frequency: Occasional (HP:0040283). (ORPHA:66624)
- Claustrophobia (HP:0025253): An abnormal fear of being in a closed or narrow space with no escape is called claustrophobia. Evidence: TAS. Frequency: Occasional (HP:0040283). (ORPHA:66624)
- Separation insecurity (HP:0031468): Fears of rejection by and/or separation from significant others are associated with fears of excessive dependency and complete loss of autonomy. Evidence: TAS. Frequency: Occasional (HP:0040283). (ORPHA:66624)
- Encopresis (HP:0040183). Evidence: TAS. Frequency: Occasional (HP:0040283). (ORPHA:66624)
Not associated with this disease:
- Mania (HP:0100754): A state of abnormally elevated or irritable mood, arousal, and/or energy levels. Evidence: TAS. (ORPHA:66624)